- Agenesis of permanent teeth (HP:0006349): A congenital defect characterized by the absence of one or more permanent teeth, including oligodontia, hypodontia, and adontia of the of permanent teeth. Evidence: TAS. Frequency: Very rare (HP:0040284). (ORPHA:821)
- Anxiety (HP:0000739): Intense feelings of nervousness, tension, or panic often arise in response to interpersonal stresses. There is worry about the negative effects of past unpleasant experiences and future negative possibilities. Individuals may feel fearful, apprehensive, or threatened by uncertainty, and they may also have fears of falling apart or losing control. Evidence: TAS. Frequency: Occasional (HP:0040283). (ORPHA:821)
- Large hands (HP:0001176). Evidence: TAS. Frequency: Occasional (HP:0040283). (ORPHA:821)
- Cerebellar vermis hypoplasia (HP:0001320): Underdevelopment of the vermis of cerebellum. Evidence: TAS. Frequency: Occasional (HP:0040283). (ORPHA:821)
- Tremor (HP:0001337): An unintentional, oscillating to-and-fro muscle movement about a joint axis. Evidence: TAS. Frequency: Occasional (HP:0040283). (ORPHA:821)
- Flexion contracture (HP:0001371): A flexion contracture is a bent (flexed) joint that cannot be straightened actively or passively. It is thus a chronic loss of joint motion due to structural changes in muscle, tendons, ligaments, or skin that prevents normal movement of joints. Evidence: TAS. Frequency: Occasional (HP:0040283). (ORPHA:821)
- Abnormal heart morphology (HP:0001627): Any structural anomaly of the heart. Evidence: TAS. Frequency: Occasional (HP:0040283). (ORPHA:821)
- Ventricular septal defect (HP:0001629): A hole between the two bottom chambers (ventricles) of the heart. The defect is centered around the most superior aspect of the ventricular septum. Evidence: TAS. Frequency: Occasional (HP:0040283). (ORPHA:821)
- Atrial septal defect (HP:0001631): Atrial septal defect (ASD) is a congenital abnormality of the interatrial septum that enables blood flow between the left and right atria via the interatrial septum. Evidence: TAS. Frequency: Occasional (HP:0040283). (ORPHA:821)
- Patent ductus arteriosus (HP:0001643): In utero, the ductus arteriosus (DA) serves to divert ventricular output away from the lungs and toward the placenta by connecting the main pulmonary artery to the descending aorta. A patent ductus arteriosus (PDA) in the first 3 days of life is a physiologic shunt in healthy term and preterm newborn infants, and normally is substantially closed within about 24 hours after bith and completely closed after about three weeks. Failure of physiologcal closure is referred to a persistent or patent ductus arteriosus (PDA). Depending on the degree of left-to-right shunting, PDA can have clinical consequences. Evidence: TAS. Frequency: Occasional (HP:0040283). (ORPHA:821)
- Pes planus (HP:0001763): A foot where the longitudinal arch of the foot is in contact with the ground or floor when the individual is standing; or, in a patient lying supine, a foot where the arch is in contact with the surface of a flat board pressed against the sole of the foot by the examiner with a pressure similar to that expected from weight bearing; or, the height of the arch is reduced. Evidence: TAS. Frequency: Occasional (HP:0040283). (ORPHA:821)
- Gastroesophageal reflux (HP:0002020): A condition in which the stomach contents leak backwards from the stomach into the esophagus through the lower esophageal sphincter. Evidence: TAS. Frequency: Occasional (HP:0040283). (ORPHA:821)
- Cerebral atrophy (HP:0002059): Atrophy (wasting, decrease in size of cells or tissue) affecting the cerebrum. Evidence: TAS. Frequency: Occasional (HP:0040283). (ORPHA:821)
- Bilateral tonic-clonic seizure (HP:0002069): A bilateral tonic-clonic seizure is a seizure defined by a tonic (bilateral increased tone, lasting seconds to minutes) and then a clonic (bilateral sustained rhythmic jerking) phase. Evidence: TAS. Frequency: Occasional (HP:0040283). (ORPHA:821)
- Ventriculomegaly (HP:0002119): An increase in size of the ventricular system of the brain. Evidence: TAS. Frequency: Occasional (HP:0040283). (ORPHA:821)
- Generalized non-motor (absence) seizure (HP:0002121): A generalized non-motor (absence) seizure is a type of a type of dialeptic seizure that is of electrographically generalized onset. It is a generalized seizure characterized by an interruption of activities, a blank stare, and usually the person will be unresponsive when spoken to. Any ictal motor phenomena are minor in comparison to these non-motor features. Evidence: TAS. Frequency: Occasional (HP:0040283). (ORPHA:821)
- Generalized myoclonic seizure (HP:0002123): A generalized myoclonic seizure is a type of generalized motor seizure characterized by bilateral, sudden, brief (<100 ms) involuntary single or multiple contraction of muscles or muscle groups of variable topography (axial, proximal limb, distal). Myoclonus is less regularly repetitive and less sustained than is clonus. Evidence: TAS. Frequency: Occasional (HP:0040283). (ORPHA:821)
- Enlarged cisterna magna (HP:0002280): Increase in size of the cisterna magna, one of three principal openings in the subarachnoid space between the arachnoid and pia mater, located between the cerebellum and the dorsal surface of the medulla oblongata. Evidence: TAS. Frequency: Occasional (HP:0040283). (ORPHA:821)
- Moderate intellectual disability (HP:0002342): Moderate intellectual disability (ID) is defined as a type of ID characterized by moderately sub-average adaptive functioning and intellectual functioning, with an intelligence quotient (IQ) the range of 35-49. Evidence: TAS. Frequency: Occasional (HP:0040283). (ORPHA:821)
- Incoordination (HP:0002311): A deficit in coordination of muscle movements. Coordination is defined as the orchestrated movement of multiple body parts as required to accomplish intended actions, like walking. Evidence: TAS. Frequency: Occasional (HP:0040283). (ORPHA:821)
- Focal impaired awareness seizure (HP:0002384): Focal impaired awareness seizure (or focal seizure with impaired or lost awareness) is a type of focal-onset seizure characterized by some degree (which may be partial) of impairment of the person's awareness of themselves or their surroundings at any point during the seizure. Evidence: TAS. Frequency: Occasional (HP:0040283). (ORPHA:821)
- Cavum septum pellucidum (HP:0002389): If the two laminae of the septum pellucidum are not fused then a fluid-filled space or cavum is present. The cavum septum pellucidum is present at birth but usually obliterates by the age of 3 to 6 months. It is up to 1cm in width and the walls are parallel. It is an enclosed space and is not part of the ventricular system or connected with the subarachnoid space. Evidence: TAS. Frequency: Occasional (HP:0040283). (ORPHA:821)
- Dyscalculia (HP:0002442): A specific learning disability involving mathematics and arithmetic. Evidence: TAS. Frequency: Occasional (HP:0040283). (ORPHA:821)
- Kyphosis (HP:0002808): Exaggerated anterior convexity of the thoracic vertebral column. Evidence: TAS. Frequency: Occasional (HP:0040283). (ORPHA:821)
- Aortic aneurysm (HP:0004942): Aortic dilatation refers to a dimension that is greater than the 95th percentile for the normal person age, sex and body size. In contrast, an aneurysm is defined as a localized dilation of the aorta that is more than 150 percent of predicted (ratio of observed to expected diameter 1.5 or more). Aneurysm should be distinguished from ectasia, which represents a diffuse dilation of the aorta less than 50 percent of normal aorta diameter. Evidence: TAS. Frequency: Occasional (HP:0040283). (ORPHA:821)
- Aplasia/Hypoplasia of the corpus callosum (HP:0007370): Absence or underdevelopment of the corpus callosum. Evidence: TAS. Frequency: Occasional (HP:0040283). (ORPHA:821)
- Pedal edema (HP:0010741): An abnormal accumulation of excess fluid in the lower extremity resulting in swelling of the feet and extending upward to the lower leg. Evidence: TAS. Frequency: Occasional (HP:0040283). (ORPHA:821)
- Severe intellectual disability (HP:0010864): Severe intellectual disability (ID) is defined as a type of ID characterized by severely sub-average adaptive functioning and intellectual functioning, with an intelligence quotient (IQ) the range of 20-34. Evidence: TAS. Frequency: Occasional (HP:0040283). (ORPHA:821)
- Inguinal hernia (HP:0000023): Protrusion of the contents of the abdominal cavity through the inguinal canal. Evidence: TAS. Frequency: Very rare (HP:0040284). (ORPHA:821)
- Cryptorchidism (HP:0000028): Testis in inguinal canal. That is, absence of one or both testes from the scrotum owing to failure of the testis or testes to descend through the inguinal canal to the scrotum. Evidence: TAS. Frequency: Very rare (HP:0040284). (ORPHA:821)
- Hydrocele testis (HP:0000034): Accumulation of clear fluid in the between the layers of membrane (tunica vaginalis) surrounding the testis. Evidence: TAS. Frequency: Very rare (HP:0040284). (ORPHA:821)
- Hypospadias (HP:0000047): Abnormal position of urethral meatus on the ventral penile shaft (underside) characterized by displacement of the urethral meatus from the tip of the glans penis to the ventral surface of the penis, scrotum, or perineum. Evidence: TAS. Frequency: Very rare (HP:0040284). (ORPHA:821)
- Ureteral duplication (HP:0000073): A developmental anomaly characterized by the presence of two, instead of one, ureter connecting a kidney to the bladder. Evidence: TAS. Frequency: Very rare (HP:0040284). (ORPHA:821)
- Ureteropelvic junction obstruction (HP:0000074): Blockage of urine flow from the renal pelvis to the proximal ureter. Evidence: TAS. Frequency: Very rare (HP:0040284). (ORPHA:821)
- Renal agenesis (HP:0000104): Agenesis, that is, failure of the kidney to develop during embryogenesis and development. Evidence: TAS. Frequency: Very rare (HP:0040284). (ORPHA:821)
- Hydronephrosis (HP:0000126): Severe distention of the kidney with dilation of the renal pelvis and calices. Evidence: TAS. Frequency: Very rare (HP:0040284). (ORPHA:821)
- Decreased fertility (HP:0000144). Evidence: TAS. Frequency: Very rare (HP:0040284). (ORPHA:821)
- Conductive hearing impairment (HP:0000405): An abnormality of vibrational conductance of sound to the inner ear leading to impairment of sensory perception of sound. Evidence: TAS. Frequency: Very rare (HP:0040284). (ORPHA:821)
- Strabismus (HP:0000486): A misalignment of the eyes so that the visual axes deviate from bifoveal fixation. The classification of strabismus may be based on a number of features including the relative position of the eyes, whether the deviation is latent or manifest, intermittent or constant, concomitant or otherwise and according to the age of onset and the relevance of any associated refractive error. Evidence: TAS. Frequency: Very rare (HP:0040284). (ORPHA:821)
- Cataract (HP:0000518): A cataract is an opacity or clouding that develops in the crystalline lens of the eye or in its capsule. Evidence: TAS. Frequency: Very rare (HP:0040284). (ORPHA:821)
- Hypermetropia (HP:0000540): An abnormality of refraction characterized by the ability to see objects in the distance clearly, while objects nearby appear blurry. Evidence: TAS. Frequency: Very rare (HP:0040284). (ORPHA:821)
- Myopia (HP:0000545): An abnormality of refraction characterized by the ability to see objects nearby clearly, while objects in the distance appear blurry. Evidence: TAS. Frequency: Very rare (HP:0040284). (ORPHA:821)
- Nystagmus (HP:0000639): Rhythmic, involuntary oscillations of one or both eyes related to abnormality in fixation, conjugate gaze, or vestibular mechanisms. Evidence: TAS. Frequency: Very rare (HP:0040284). (ORPHA:821)
- Hypodontia (HP:0000668): The absence of five or less teeth from the normal series by a failure to develop. Evidence: TAS. Frequency: Very rare (HP:0040284). (ORPHA:821)
- Delayed eruption of permanent teeth (HP:0000696): Delayed tooth eruption affecting the secondary dentition. Evidence: TAS. Frequency: Very rare (HP:0040284). (ORPHA:821)
- Pectus excavatum (HP:0000767): A defect of the chest wall characterized by a depression of the sternum, giving the chest ("pectus") a caved-in ("excavatum") appearance. Evidence: TAS. Frequency: Very rare (HP:0040284). (ORPHA:821)
- Hypothyroidism (HP:0000821): Deficiency of thyroid hormone. Evidence: TAS. Frequency: Very rare (HP:0040284). (ORPHA:821)
- Hyperpigmentation of the skin (HP:0000953): A darkening of the skin related to an increase in melanin production and deposition. Evidence: TAS. Frequency: Very rare (HP:0040284). (ORPHA:821)
- Hypopigmentation of the skin (HP:0001010): A reduction of skin color related to a decrease in melanin production and deposition. Evidence: TAS. Frequency: Very rare (HP:0040284). (ORPHA:821)
- Hemangioma (HP:0001028): A hemangioma is a benign tumor characterized by blood-filled spaces lined by benign endothelial cells. A hemangioma characterized by large endothelial spaces (caverns) is called a cavernous hemangioma (in contrast to a hemangioma with small endothelial spaces, which is called capillary hemangioma). Evidence: TAS. Frequency: Very rare (HP:0040284). (ORPHA:821)
- Craniosynostosis (HP:0001363): Craniosynostosis refers to the premature closure of the cranial sutures. Primary craniosynostosis refers to the closure of one or more sutures due to abnormalities in skull development, and secondary craniosynostosis results from failure of brain growth. Evidence: TAS. Frequency: Very rare (HP:0040284). (ORPHA:821)
- Umbilical hernia (HP:0001537): Protrusion of abdominal contents through a defect in the abdominal wall musculature around the umbilicus. Skin and subcutaneous tissue overlie the defect. Evidence: TAS. Frequency: Very rare (HP:0040284). (ORPHA:821)
- Phimosis (HP:0001741): The male foreskin cannot be fully retracted from the head of the penis. Evidence: TAS. Frequency: Very rare (HP:0040284). (ORPHA:821)
- Talipes equinovarus (HP:0001762): Talipes equinovarus (also called clubfoot) typically has four main components: inversion and adduction of the forefoot; inversion of the heel and hindfoot; equinus (limitation of extension) of the ankle and subtalar joint; and internal rotation of the leg. Evidence: TAS. Frequency: Very rare (HP:0040284). (ORPHA:821)
- Small nail (HP:0001792): A nail that is diminished in length and width, i.e., underdeveloped nail. Evidence: TAS. Frequency: Very rare (HP:0040284). (ORPHA:821)
- Neonatal hypoglycemia (HP:0001998). Evidence: TAS. Frequency: Very rare (HP:0040284). (ORPHA:821)
- Aganglionic megacolon (HP:0002251): An abnormality resulting from a lack of intestinal ganglion cells (i.e., an aganglionic section of bowel) that results in bowel obstruction with enlargement of the colon. Evidence: TAS. Frequency: Very rare (HP:0040284). (ORPHA:821)
- Neoplasm (HP:0002664): An organ or organ-system abnormality that consists of uncontrolled autonomous cell-proliferation which can occur in any part of the body as a benign or malignant neoplasm (tumor). Evidence: TAS. Frequency: Very rare (HP:0040284). (ORPHA:821)
- Neuroblastoma (HP:0003006): Neuroblastoma is a solid tumor that originate in neural crest cells of the sympathetic nervous system. Most neuroblastomas originate in the abdomen, and most abdominal neuroblastomas originate in the adrenal gland. Neuroblastomas can also originate in the thorax, usually in the posterior mediastinum. Evidence: TAS. Frequency: Very rare (HP:0040284). (ORPHA:821)
- Hypercalcemia (HP:0003072): The concentration of calcium in the blood circulation is above the upper limit of normal. Evidence: TAS. Frequency: Very rare (HP:0040284). (ORPHA:821)
- Hip contracture (HP:0003273): Lack of full passive range of motion (restrictions in flexion, extension, or other movements) of the hip joint resulting from structural changes of non-bony tissues, such as muscles, tendons, ligaments, joint capsules and/or skin. Evidence: TAS. Frequency: Very rare (HP:0040284). (ORPHA:821)
- Abnormal vertebral morphology (HP:0003468): An abnormality of one or more of the vertebrae. Evidence: TAS. Frequency: Very rare (HP:0040284). (ORPHA:821)
- Tall stature (HP:0000098): A height above that which is expected according to age and gender norms. Evidence: TAS. Frequency: Very frequent (HP:0040281). (ORPHA:821)
- Coarse facial features (HP:0000280): Absence of fine and sharp appearance of brows, nose, lips, mouth, and chin, usually because of rounded and heavy features or thickened skin with or without thickening of subcutaneous and bony tissues. Evidence: TAS. Frequency: Very frequent (HP:0040281). (ORPHA:821)
- Increased arm span (HP:0012771): Increased length of the arm span (length from one end of an individual's arms measured at the fingertips to the other when raised parallel to the ground at shoulder height at a one-hundred eighty degree angle). Evidence: TAS. Frequency: Very frequent (HP:0040281). (ORPHA:821)
- Dolichocephaly (HP:0000268): An abnormality of skull shape characterized by a increased anterior-posterior diameter, i.e., an increased antero-posterior dimension of the skull. Cephalic index less than 76%. Alternatively, an apparently increased antero-posterior length of the head compared to width. Often due to premature closure of the sagittal suture. Evidence: TAS. Frequency: Frequent (HP:0040282). (ORPHA:821)
- Narrow face (HP:0000275): Bizygomatic (upper face) and bigonial (lower face) width are both more than 2 standard deviations below the mean (objective); or, an apparent reduction in the width of the upper and lower face (subjective). Evidence: TAS. Frequency: Frequent (HP:0040282). (ORPHA:821)
- Long face (HP:0000276): Facial height (length) is more than 2 standard deviations above the mean (objective); or, an apparent increase in the height (length) of the face (subjective). Evidence: TAS. Frequency: Frequent (HP:0040282). (ORPHA:821)
- Hearing impairment (HP:0000365): A decreased magnitude of the sensory perception of sound. Evidence: TAS. Frequency: Frequent (HP:0040282). (ORPHA:821)
- Chronic otitis media (HP:0000389): Chronic otitis media refers to fluid, swelling, or infection of the middle ear that does not heal and may cause permanent damage to the ear. Evidence: TAS. Frequency: Frequent (HP:0040282). (ORPHA:821)
- Astigmatism (HP:0000483): A type of refraction error associated with abnormal curvatures on the anterior and/or posterior surface of the cornea. Evidence: TAS. Frequency: Frequent (HP:0040282). (ORPHA:821)
- Downslanted palpebral fissures (HP:0000494): The palpebral fissure inclination is more than two standard deviations below the mean. Evidence: TAS. Frequency: Frequent (HP:0040282). (ORPHA:821)
- Atypical behavior (HP:0000708): Atypical behavior is an abnormality in a person's actions that can be controlled or modulated by the will of the individual. While abnormal behaviors can be difficult to control, they are distinct from other abnormal actions that cannot be affected by the individual's will. Evidence: TAS. Frequency: Frequent (HP:0040282). (ORPHA:821)
- Seizure (HP:0001250): A seizure is an intermittent abnormality of nervous system physiology characterized by a transient occurrence of signs and/or symptoms due to abnormal excessive or synchronous neuronal activity in the brain. Evidence: TAS. Frequency: Frequent (HP:0040282). (ORPHA:821)
- Hypotonia (HP:0001252): Hypotonia is an abnormally low muscle tone (the amount of tension or resistance to movement in a muscle). Even when relaxed, muscles have a continuous and passive partial contraction which provides some resistance to passive stretching. Hypotonia thus manifests as diminished resistance to passive stretching. Hypotonia is not the same as muscle weakness, although the two conditions can co-exist. Evidence: TAS. Frequency: Frequent (HP:0040282). (ORPHA:821)
- Mild intellectual disability (HP:0001256): Mild intellectual disability (ID) is defined as a type of ID characterized by mildly sub-average adaptive functioning and intellectual functioning, with an intelligence quotient (IQ) the range of 50-69. Evidence: TAS. Frequency: Frequent (HP:0040282). (ORPHA:821)
- Global developmental delay (HP:0001263): A delay in the achievement of motor or mental milestones in the domains of development of a child, including motor skills, speech and language, cognitive skills, and social and emotional skills. This term should only be used to describe children younger than five years of age. Evidence: TAS. Frequency: Frequent (HP:0040282). (ORPHA:821)
- Constipation (HP:0002019): Infrequent or difficult evacuation of feces. Evidence: TAS. Frequency: Frequent (HP:0040282). (ORPHA:821)
- Scoliosis (HP:0002650): The presence of an abnormal lateral curvature of the spine. Evidence: TAS. Frequency: Frequent (HP:0040282). (ORPHA:821)
- Sparse anterior scalp hair (HP:0004768): Decreased number of head hairs per unit area on the anterior region of the scalp. Evidence: TAS. Frequency: Frequent (HP:0040282). (ORPHA:821)
- Accelerated skeletal maturation (HP:0005616): An abnormally increased rate of skeletal maturation. Accelerated skeletal maturation can be diagnosed on the basis of an estimation of the bone age from radiographs of specific bones in the human body. Evidence: TAS. Frequency: Frequent (HP:0040282). (ORPHA:821)
- Prolonged neonatal jaundice (HP:0006579): Neonatal jaundice refers to a yellowing of the skin and other tissues of a newborn infant as a result of increased concentrations of bilirubin in the blood. Neonatal jaundice affects over half of all newborns to some extent in the first week of life. Prolonged neonatal jaundice is said to be present if the jaundice persists for longer than 14 days in term infants and 21 days in preterm infants. Evidence: TAS. Frequency: Frequent (HP:0040282). (ORPHA:821)
- Prominent forehead (HP:0011220): Forward prominence of the entire forehead, due to protrusion of the frontal bone. Evidence: TAS. Frequency: Frequent (HP:0040282). (ORPHA:821)
- Feeding difficulties (HP:0011968): Impaired ability to eat related to problems gathering food and getting ready to suck, chew, or swallow it. Evidence: TAS. Frequency: Frequent (HP:0040282). (ORPHA:821)
- Flushing (HP:0031284): Recurrent episodes of redness of the skin together with a sensation of warmth or burning of the affected areas of skin. Evidence: TAS. Frequency: Frequent (HP:0040282). (ORPHA:821)
- Increased head circumference (HP:0040194): An abnormally increased head circumference in a growing child. Head circumference is measured with a nonelastic tape and comprises the distance from above the eyebrows and ears and around the back of the head. The measured HC is then plotted on an appropriate growth chart. Evidence: TAS. Frequency: Frequent (HP:0040282). (ORPHA:821)
- Tall chin (HP:0400000): Increased vertical distance from the vermillion border of the lower lip to the inferior-most point of the chin. Evidence: TAS. Frequency: Frequent (HP:0040282). (ORPHA:821)
- Brain imaging abnormality (HP:0410263): An anomaly of metabolism or structure of the brain identified by imaging. Evidence: TAS. Frequency: Frequent (HP:0040282). (ORPHA:821)
- Vesicoureteral reflux (HP:0000076): Abnormal (retrograde) movement of urine from the bladder into ureters or kidneys related to inadequacy of the valvular mechanism at the ureterovesicular junction or other causes. Evidence: TAS. Frequency: Occasional (HP:0040283). (ORPHA:821)
- Abnormality of the kidney (HP:0000077): An abnormality of the kidney. Evidence: TAS. Frequency: Occasional (HP:0040283). (ORPHA:821)
- Renal insufficiency (HP:0000083): A reduction in the level of performance of the kidneys in areas of function comprising the concentration of urine, removal of wastes, the maintenance of electrolyte balance, homeostasis of blood pressure, and calcium metabolism. Evidence: TAS. Frequency: Occasional (HP:0040283). (ORPHA:821)
- Abnormality of the dentition (HP:0000164): Any abnormality of the teeth. Evidence: TAS. Frequency: Occasional (HP:0040283). (ORPHA:821)
- Macrocephaly (HP:0000256): Occipitofrontal (head) circumference greater than 97th centile compared to appropriate, age matched, sex-matched normal standards. Alternatively, a apparently increased size of the cranium. Evidence: TAS. Frequency: Occasional (HP:0040283). (ORPHA:821)
- Aggressive behavior (HP:0000718): Behavior or an act aimed at harming a person, animal, or physical property (e.g., acts of physical violence; shouting, swearing, and using harsh language; slashing someone's tires). Evidence: TAS. Frequency: Occasional (HP:0040283). (ORPHA:821)
- Autistic behavior (HP:0000729): Persistent deficits in social interaction and communication and interaction as well as a markedly restricted repertoire of activity and interest as well as repetitive patterns of behavior. Evidence: TAS. Frequency: Occasional (HP:0040283). (ORPHA:821)
- 2-3 toe syndactyly (HP:0004691): Syndactyly with fusion of toes two and three. Evidence: TAS. Frequency: Very rare (HP:0040284). (ORPHA:821)
- Bilateral camptodactyly (HP:0005617). Evidence: TAS. Frequency: Very rare (HP:0040284). (ORPHA:821)
- Ankle flexion contracture (HP:0006466). Evidence: TAS. Frequency: Very rare (HP:0040284). (ORPHA:821)
- Acute lymphoblastic leukemia (HP:0006721): A form of acute leukemia characterized by excess lympoblasts. Evidence: TAS. Frequency: Very rare (HP:0040284). (ORPHA:821)
- Attention deficit hyperactivity disorder (HP:0007018): Attention deficit hyperactivity disorder (ADHD) manifests at age 2-3 years or by first grade at the latest. The main symptoms are distractibility, impulsivity, hyperactivity, and often trouble organizing tasks and projects, difficulty going to sleep, and social problems from being aggressive, loud, or impatient. Evidence: TAS. Frequency: Very rare (HP:0040284). (ORPHA:821)
- Astrocytoma (HP:0009592): Astrocytoma is a neoplasm of the central nervous system derived from astrocytes. Astrocytes are a type of glial cell, and thus astrocytoma is a subtype of glioma. Evidence: TAS. Frequency: Very rare (HP:0040284). (ORPHA:821)
- Cholesteatoma (HP:0009797): Cholesteatoma is a benign but potentially destructive growth consisting of keratinizing epithelium located in the middle ear and/or mastoid process. In cholesteatoma, a skin cyst grows into the middle ear and mastoid. The cyst is not cancerous but can erode tissue and cause destruction of the ear. Evidence: TAS. Frequency: Very rare (HP:0040284). (ORPHA:821)
- Congenital posterior urethral valve (HP:0010957): A developmental defect resulting in an obstructing membrane in the posterior male urethra. Evidence: TAS. Frequency: Very rare (HP:0040284). (ORPHA:821)
- Small cell lung carcinoma (HP:0030357): Small cell lung cancer (SCLC) is a type of highly malignant lung cancer that is composed of small ovoid cells. In the past, SCLC was called oat cell carcinoma because the microscopic appearance of the cells was felt to resemble oats. SLCLC usually originates near the bronchi and in many cases may grow and metastasize quickly. Evidence: TAS. Frequency: Very rare (HP:0040284). (ORPHA:821)
- Sacrococcygeal teratoma (HP:0030736): A teratoma arising in the sacro-coccygeal region. Evidence: TAS. Frequency: Very rare (HP:0040284). (ORPHA:821)
- Pulmonary bleb (HP:0032447): A bleb is a small gas-containing space within the visceral pleura or in the subpleural lung, not larger than 1 cm in diameter. CT findings show a bleb as a thin-walled cystic air space contiguous with the pleura. Evidence: TAS. Frequency: Very rare (HP:0040284). (ORPHA:821)
- Joint hypermobility (HP:0001382): The capability that a joint (or a group of joints) has to move, passively and/or actively, beyond normal limits along physiological axes. Evidence: TAS. Frequency: Frequent (HP:0040282). (ORPHA:821)
These phenotypes are associated with the disease Sotos syndrome (ORPHA:821).